- Hypoplasia of the lower eyelids (HP:0007697): Underdevelopment of the lower eyelid. Evidence: IEA. (OMIM:600269)
- Autosomal dominant inheritance (HP:0000006): A mode of inheritance that is observed for traits related to a gene encoded on one of the autosomes (i.e., the human chromosomes 1-22) in which a trait manifests in heterozygotes. In the context of medical genetics, an autosomal dominant disorder is caused when a single copy of the mutant allele is present. Males and females are affected equally, and can both transmit the disorder with a risk of 50% for each child of inheriting the mutant allele. Evidence: IEA. (OMIM:600269)
- Absent lower eyelashes (HP:0007646): Lack of eyelashes on the lower lid. Evidence: IEA. (OMIM:600269)
These phenotypes are associated with the disease short tarsus-absence of lower eyelashes syndrome (OMIM:600269).